Phenotypes associated with the disease X-linked intellectual disability-retinitis pigmentosa syndrome (ORPHA:85332):
- Intellectual disability (HP:0001249): The term intellectual disability or intellectual developmental disorder is used to describe significantly sub-average intellectual and adaptive functioning based on clinical assessment and as measured by individually administered, appropriately normed, standardized and validated tests of intellectual functioning and adaptive behavior, with onset during the developmental period from infancy through adolescence. Evidence: TAS. Frequency: Very frequent (HP:0040281). (ORPHA:85332)
- Iris hypopigmentation (HP:0007730): An abnormal reduction in the amount of pigmentation of the iris. Evidence: TAS. Frequency: Very frequent (HP:0040281). (ORPHA:85332)